- Seizure (HP:0001250): A seizure is an intermittent abnormality of nervous system physiology characterized by a transient occurrence of signs and/or symptoms due to abnormal excessive or synchronous neuronal activity in the brain. Evidence: TAS. Frequency: Very frequent (HP:0040281). (ORPHA:101029)
- Abnormality of neuronal migration (HP:0002269): An abnormality resulting from an anomaly of neuronal migration, i.e., of the process by which neurons travel from their origin to their final position in the brain. Evidence: TAS. Frequency: Very frequent (HP:0040281). (ORPHA:101029)
- Abnormal cerebral cortex morphology (HP:0002538): Any structural abnormality of the cerebral cortex. Evidence: TAS. Frequency: Very frequent (HP:0040281). (ORPHA:101029)
- Subcortical heterotopia (HP:0032391): A form of heterotopia were the mislocalized gray matter is located deep within the white matter. Evidence: TAS. Frequency: Very frequent (HP:0040281). (ORPHA:101029)
- Spasticity (HP:0001257): A motor disorder characterized by a velocity-dependent increase in tonic stretch reflexes with increased muscle tone, exaggerated (hyperexcitable) tendon reflexes. Evidence: TAS. Frequency: Frequent (HP:0040282). (ORPHA:101029)
- Muscle weakness (HP:0001324): Reduced strength of muscles. Evidence: TAS. Frequency: Frequent (HP:0040282). (ORPHA:101029)
- Specific learning disability (HP:0001328): Impairment of certain skills such as reading or writing, coordination, self-control, or attention that interfere with the ability to learn. The impairment is not related to a global deficiency of intelligence. Evidence: TAS. Frequency: Frequent (HP:0040282). (ORPHA:101029)
- Hyperreflexia (HP:0001347): Hyperreflexia is the presence of hyperactive stretch reflexes of the muscles. Evidence: TAS. Frequency: Frequent (HP:0040282). (ORPHA:101029)
- Polymicrogyria (HP:0002126): Polymicrogyria is a congenital malformation of the cerebral cortex characterized by abnormal cortical layering (lamination) and an excessive number of small gyri (folds). Evidence: TAS. Frequency: Frequent (HP:0040282). (ORPHA:101029)
- Abnormal foramen magnum morphology (HP:0002699): Any abnormality of the foramen magnum. Evidence: TAS. Frequency: Frequent (HP:0040282). (ORPHA:101029)
- EEG with focal slow activity (HP:0010843): Focal (localized) slow activity reflects focal dysfunction, not diffuse dysfunction (i.e., encephalopathy). Evidence: TAS. Frequency: Frequent (HP:0040282). (ORPHA:101029)
- EEG with focal spikes (HP:0011193): EEG with focal sharp transient waves of a duration less than 80 msec. Evidence: TAS. Frequency: Frequent (HP:0040282). (ORPHA:101029)
- Agenesis of corpus callosum (HP:0001274): Absence of the corpus callosum as a result of the failure of the corpus callosum to develop, which can be the result of a failure in any one of the multiple steps of callosal development including cellular proliferation and migration, axonal growth or glial patterning at the midline. Evidence: TAS. Frequency: Occasional (HP:0040283). (ORPHA:101029)
- Hypoplasia of the corpus callosum (HP:0002079): Underdevelopment of the corpus callosum. Evidence: TAS. Frequency: Occasional (HP:0040283). (ORPHA:101029)
- Abnormal basal ganglia morphology (HP:0002134): Abnormality of the basal ganglia. Evidence: TAS. Frequency: Occasional (HP:0040283). (ORPHA:101029)
These phenotypes are associated with the disease Sub-cortical nodular heterotopia (ORPHA:101029).